Phenotypes associated with the disease intellectual developmental disorder with gastrointestinal difficulties and high pain threshold (OMIM:617450):
- Small nail (HP:0001792): A nail that is diminished in length and width, i.e., underdeveloped nail. Evidence: PCS. Frequency: 6/12. (PMID:28343630)
- Short foot (HP:0001773): A measured foot length that is more than 2 SD below the mean for a newborn of 27 - 41 weeks gestation, or foot that is less than the 3rd centile for individuals from birth to 16 years of age (objective). Alternatively, a foot that appears disproportionately short (subjective). Evidence: PCS. Frequency: 7/8. (PMID:28343630)
- Strabismus (HP:0000486): A misalignment of the eyes so that the visual axes deviate from bifoveal fixation. The classification of strabismus may be based on a number of features including the relative position of the eyes, whether the deviation is latent or manifest, intermittent or constant, concomitant or otherwise and according to the age of onset and the relevance of any associated refractive error. Evidence: PCS. Frequency: 7/14. (PMID:28343630)
- Anteverted nares (HP:0000463): Anteriorly-facing nostrils viewed with the head in the Frankfurt horizontal and the eyes of the observer level with the eyes of the subject. This gives the appearance of an upturned nose (upturned nasal tip). Evidence: PCS. Frequency: 5/12. (PMID:28343630)
- Brachydactyly (HP:0001156): Digits that appear disproportionately short compared to the hand/foot. The word brachydactyly is used here to describe a series distinct patterns of shortened digits (brachydactyly types A-E). This is the sense used here. Evidence: TAS. (OMIM:617450)
- Hypermetropia (HP:0000540): An abnormality of refraction characterized by the ability to see objects in the distance clearly, while objects nearby appear blurry. Evidence: PCS. Frequency: 5/14. (PMID:28343630)
- Short stature (HP:0004322): A height below that which is expected according to age and gender norms. Although there is no universally accepted definition of short stature, many refer to "short stature" as height more than 2 standard deviations below the mean for age and gender (or below the 3rd percentile for age and gender dependent norms). Evidence: PCS. Frequency: 9/12. (PMID:28343630)
- Hypotonia (HP:0001252): Hypotonia is an abnormally low muscle tone (the amount of tension or resistance to movement in a muscle). Even when relaxed, muscles have a continuous and passive partial contraction which provides some resistance to passive stretching. Hypotonia thus manifests as diminished resistance to passive stretching. Hypotonia is not the same as muscle weakness, although the two conditions can co-exist. Evidence: PCS. Frequency: 10/14. (PMID:28343630)
- Gastroesophageal reflux (HP:0002020): A condition in which the stomach contents leak backwards from the stomach into the esophagus through the lower esophageal sphincter. Evidence: PCS. Frequency: 10/13. (PMID:28343630)
- Recurrent infections (HP:0002719): Increased susceptibility to infections as manifested by repeated bouts of infection. Evidence: PCS. Frequency: 5/9. (PMID:28343630)
- Ventricular septal defect (HP:0001629): A hole between the two bottom chambers (ventricles) of the heart. The defect is centered around the most superior aspect of the ventricular septum. Evidence: PCS. Frequency: 1/14. (PMID:28343630)
- Anxiety (HP:0000739): Intense feelings of nervousness, tension, or panic often arise in response to interpersonal stresses. There is worry about the negative effects of past unpleasant experiences and future negative possibilities. Individuals may feel fearful, apprehensive, or threatened by uncertainty, and they may also have fears of falling apart or losing control. Evidence: PCS. Frequency: 4/14. (PMID:28343630)
- Bicuspid aortic valve (HP:0001647): The presence of an aortic valve with two instead of the normal three cusps (flaps). Bicuspid aortic valvue is a malformation of a commissure (small space between the attachment of each cusp to the aortic wall) and the adjacent parts of the two corresponding cusps forming a raphe (the fused area of the two underdeveloped cusps turning into a malformed commissure between both cusps; the raphe is a fibrous ridge that extends from the commissure to the free edge of the two underdeveloped, conjoint cusps). Evidence: PCS. Frequency: 1/14. (PMID:28343630)
- Broad forehead (HP:0000337): Width of the forehead or distance between the frontotemporales is more than two standard deviations above the mean (objective); or apparently increased distance between the two sides of the forehead. Evidence: PCS. Frequency: 8/12. (PMID:28343630)
- Hyperlordosis (HP:0003307): Abnormally increased curvature (anterior concavity) of the lumbar or cervical spine. Evidence: PCS. Frequency: 7/10. (PMID:28343630)
- Thin upper lip vermilion (HP:0000219): Height of the vermilion of the upper lip in the midline more than 2 SD below the mean. Alternatively, an apparently reduced height of the vermilion of the upper lip in the frontal view (subjective). Evidence: PCS. Frequency: 10/12. (PMID:28343630)
- Constipation (HP:0002019): Infrequent or difficult evacuation of feces. Evidence: PCS. Frequency: 8/13. (PMID:28343630)
- Intellectual disability (HP:0001249): The term intellectual disability or intellectual developmental disorder is used to describe significantly sub-average intellectual and adaptive functioning based on clinical assessment and as measured by individually administered, appropriately normed, standardized and validated tests of intellectual functioning and adaptive behavior, with onset during the developmental period from infancy through adolescence. Evidence: PCS. Frequency: 13/14. (PMID:28343630)
- Laryngomalacia (HP:0001601): Laryngomalacia is a congenital abnormality of the laryngeal cartilage in which the cartilage is floppy and prolapses over the larynx during inspiration. Evidence: PCS. Frequency: 1/14. (PMID:28343630)
- Posteriorly rotated ears (HP:0000358): A type of abnormal location of the ears in which the position of the ears is characterized by posterior rotation (the superior part of the ears is rotated towards the back of the head, and the inferior part of the ears towards the front). Evidence: PCS. Frequency: 8/10. (PMID:28343630)
- Wide mouth (HP:0000154): Distance between the oral commissures more than 2 SD above the mean. Alternatively, an apparently increased width of the oral aperture (subjective). Evidence: PCS. Frequency: 6/12. (PMID:28343630)
- Broad-based gait (HP:0002136): An abnormal gait pattern in which persons stand and walk with their feet spaced widely apart. This is often a component of cerebellar ataxia. Evidence: PCS. Frequency: 5/10. (PMID:28343630)
- Parietal foramina (HP:0002697): The presence of symmetrical and circular openings (foramina) in the parietal bone ranging in size from a few millimeters to several centimeters wide. Evidence: PCS. Frequency: 1/14. (PMID:28343630)
- Delayed speech and language development (HP:0000750): A degree of language development that is significantly below the norm for a child of a specified age. Evidence: PCS. (PMID:28343630)
- Vomiting (HP:0002013): Forceful ejection of the contents of the stomach through the mouth by means of a series of involuntary spasmic contractions. Evidence: PCS. (PMID:28343630)
- Feeding difficulties (HP:0011968): Impaired ability to eat related to problems gathering food and getting ready to suck, chew, or swallow it. Evidence: PCS. Frequency: 10/14. (PMID:28343630)
- Global developmental delay (HP:0001263): A delay in the achievement of motor or mental milestones in the domains of development of a child, including motor skills, speech and language, cognitive skills, and social and emotional skills. This term should only be used to describe children younger than five years of age. Evidence: PCS. (PMID:28343630)
- Central diaphragmatic hernia (HP:0025195): A congenital diaphragm defect involving the central tendinous (e.g., amuscular) portion of the diaphragm, whereby the entire rim of diaphragmatic musculature is present. Evidence: PCS. Frequency: 1/14. (PMID:28343630)
- Autistic behavior (HP:0000729): Persistent deficits in social interaction and communication and interaction as well as a markedly restricted repertoire of activity and interest as well as repetitive patterns of behavior. Evidence: PCS. Frequency: 4/14. (PMID:28343630)
- Hyperacusis (HP:0010780): Over-sensitivity to certain frequency ranges of sound. Evidence: PCS. Frequency: 7/7. (PMID:28343630)
- Compulsive behaviors (HP:0000722): Behavior that consists of repetitive acts, characterized by the feeling that one "has to" perform them, while being aware that these acts are not in line with one's overall goal. Evidence: PCS. Frequency: 1/14. (PMID:28343630)
- Small hand (HP:0200055): Disproportionately small hand. Evidence: PCS. Frequency: 10/11. (PMID:28343630)
- Attention deficit hyperactivity disorder (HP:0007018): Attention deficit hyperactivity disorder (ADHD) manifests at age 2-3 years or by first grade at the latest. The main symptoms are distractibility, impulsivity, hyperactivity, and often trouble organizing tasks and projects, difficulty going to sleep, and social problems from being aggressive, loud, or impatient. Evidence: PCS. Frequency: 1/14. (PMID:28343630)
- Autosomal dominant inheritance (HP:0000006): A mode of inheritance that is observed for traits related to a gene encoded on one of the autosomes (i.e., the human chromosomes 1-22) in which a trait manifests in heterozygotes. In the context of medical genetics, an autosomal dominant disorder is caused when a single copy of the mutant allele is present. Males and females are affected equally, and can both transmit the disorder with a risk of 50% for each child of inheriting the mutant allele. Evidence: PCS. (PMID:28343630)
- Low-set ears (HP:0000369): Upper insertion of the ear to the scalp below an imaginary horizontal line drawn between the inner canthi of the eye and extending posteriorly to the ear. Evidence: PCS. Frequency: 7/10. (PMID:28343630)